Phenotypes associated with the disease Erythema elevatum diutinum (ORPHA:90000):
- Skin rash (HP:0000988): A red eruption of the skin. Evidence: TAS. Frequency: Very frequent (HP:0040281). (ORPHA:90000)
- Arthralgia (HP:0002829): Joint pain. Evidence: TAS. Frequency: Very frequent (HP:0040281). (ORPHA:90000)
- Myalgia (HP:0003326): Pain in muscle. Evidence: TAS. Frequency: Occasional (HP:0040283). (ORPHA:90000)
- Abnormal blistering of the skin (HP:0008066): The presence of one or more bullae on the skin, defined as fluid-filled blisters more than 5 mm in diameter with thin walls. Evidence: TAS. Frequency: Frequent (HP:0040282). (ORPHA:90000)
- Increased circulating immunoglobulin concentration (HP:0010702): An increased level of gamma globulin (immunoglobulin) in the blood. Evidence: TAS. Frequency: Frequent (HP:0040282). (ORPHA:90000)
- Vasculitis in the skin (HP:0200029): A type of vasculitis (inflammation of blood vessel walls) that affects skeletal muscle tissue. Evidence: TAS. Frequency: Very frequent (HP:0040281). (ORPHA:90000)
- Skin nodule (HP:0200036): Morphologically similar to a papule, but greater than either 10mm in both width and depth, and most frequently centered in the dermis or subcutaneous fat. Evidence: TAS. Frequency: Occasional (HP:0040283). (ORPHA:90000)
- Skin vesicle (HP:0200037): A circumscribed, fluid-containing, epidermal elevation less than 10mm in diameter at the widest point that (i) Contain serous exudates or serum mixed with blood or pus; (ii) Are discrete, grouped, irregularly distributed, or linear as in Rhus dermatitis; (iii) Are short-lived. Vesicles may break spontaneously or evolve into bullae by enlarging or coalescing with other vesicles. Evidence: TAS. Frequency: Frequent (HP:0040282). (ORPHA:90000)